- Abnormality of the nervous system (HP:0000707): An abnormality of the nervous system. Evidence: IEA. (OMIM:244100)
- Autosomal recessive inheritance (HP:0000007): A mode of inheritance that is observed for traits related to a gene encoded on one of the autosomes (i.e., the human chromosomes 1-22) in which a trait manifests in individuals with two pathogenic alleles, either homozygotes (two copies of the same mutant allele) or compound heterozygotes (whereby each copy of a gene has a distinct mutant allele). Evidence: IEA. (OMIM:244100)
These phenotypes are associated with the disease Jumping Frenchmen of Maine (OMIM:244100).